- Macrocephaly (HP:0000256): Occipitofrontal (head) circumference greater than 97th centile compared to appropriate, age matched, sex-matched normal standards. Alternatively, a apparently increased size of the cranium. Evidence: TAS. Frequency: Frequent (HP:0040282). (ORPHA:500095)
- Sensorineural hearing impairment (HP:0000407): A type of hearing impairment in one or both ears related to an abnormal functionality of the cochlear nerve. Evidence: TAS. Frequency: Frequent (HP:0040282). (ORPHA:500095)
- Retinal coloboma (HP:0000480): A notch or cleft of the retina or choroid, located vertically below the optic disc. Evidence: TAS. Frequency: Frequent (HP:0040282). (ORPHA:500095)
- Downslanted palpebral fissures (HP:0000494): The palpebral fissure inclination is more than two standard deviations below the mean. Evidence: TAS. Frequency: Frequent (HP:0040282). (ORPHA:500095)
- Intellectual disability (HP:0001249): The term intellectual disability or intellectual developmental disorder is used to describe significantly sub-average intellectual and adaptive functioning based on clinical assessment and as measured by individually administered, appropriately normed, standardized and validated tests of intellectual functioning and adaptive behavior, with onset during the developmental period from infancy through adolescence. Evidence: TAS. Frequency: Frequent (HP:0040282). (ORPHA:500095)
- Global developmental delay (HP:0001263): A delay in the achievement of motor or mental milestones in the domains of development of a child, including motor skills, speech and language, cognitive skills, and social and emotional skills. This term should only be used to describe children younger than five years of age. Evidence: TAS. Frequency: Frequent (HP:0040282). (ORPHA:500095)
- Specific learning disability (HP:0001328): Impairment of certain skills such as reading or writing, coordination, self-control, or attention that interfere with the ability to learn. The impairment is not related to a global deficiency of intelligence. Evidence: TAS. Frequency: Frequent (HP:0040282). (ORPHA:500095)
- Large for gestational age (HP:0001520): The term large for gestational age applies to babies whose birth weight lies above the 90th percentile for that gestational age. Evidence: TAS. Frequency: Frequent (HP:0040282). (ORPHA:500095)
- Ventricular septal defect (HP:0001629): A hole between the two bottom chambers (ventricles) of the heart. The defect is centered around the most superior aspect of the ventricular septum. Evidence: TAS. Frequency: Frequent (HP:0040282). (ORPHA:500095)
- Mitral valve prolapse (HP:0001634): One or both of the leaflets (cusps) of the mitral valve bulges back into the left atrium upon contraction of the left ventricle. Evidence: TAS. Frequency: Frequent (HP:0040282). (ORPHA:500095)
- Abnormal facial shape (HP:0001999): An abnormal morphology (form) of the face or its components. Evidence: TAS. Frequency: Frequent (HP:0040282). (ORPHA:500095)
- Renal malrotation (HP:0004712): An abnormality of the normal developmental rotation of the kidney leading to an abnormal orientation of the kidney. Evidence: TAS. Frequency: Frequent (HP:0040282). (ORPHA:500095)
- Proportionate tall stature (HP:0011407). Evidence: TAS. Frequency: Frequent (HP:0040282). (ORPHA:500095)
- Camptodactyly (HP:0012385): The distal interphalangeal joint and/or the proximal interphalangeal joint of the fingers or toes cannot be extended to 180 degrees by either active or passive extension. Evidence: TAS. Frequency: Frequent (HP:0040282). (ORPHA:500095)
- Thick vermilion border (HP:0012471): Increased width of the skin of vermilion border region of upper lip. Evidence: TAS. Frequency: Frequent (HP:0040282). (ORPHA:500095)
- Bifid ureter (HP:0030037): Incomplete duplication of the ureter. Evidence: TAS. Frequency: Frequent (HP:0040282). (ORPHA:500095)
- Persistently decreased total neutrophil count (HP:0410252): Abnormal decrease of the absolute number of neutrophils in the blood, per microlitre, compared to a reference range for a given sex and age-group, which persists for 3 or more months. Evidence: TAS. Frequency: Frequent (HP:0040282). (ORPHA:500095)
- Transiently decreased total neutrophil count (HP:0410255): Abnormal decrease of the absolute number of neutrophils in the blood, per microlitre, compared to a reference range for a given sex and age-group, which persists for less than 3 months and then spontaneously recovers, but does not recur cyclically. Evidence: TAS. Frequency: Frequent (HP:0040282). (ORPHA:500095)
- Multicystic kidney dysplasia (HP:0000003): Multicystic dysplasia of the kidney is characterized by multiple cysts of varying size in the kidney and the absence of a normal pelvicaliceal system. The condition is associated with ureteral or ureteropelvic atresia, and the affected kidney is nonfunctional. Evidence: TAS. Frequency: Occasional (HP:0040283). (ORPHA:500095)
- Inguinal hernia (HP:0000023): Protrusion of the contents of the abdominal cavity through the inguinal canal. Evidence: TAS. Frequency: Occasional (HP:0040283). (ORPHA:500095)
- Enlarged kidney (HP:0000105): An abnormal increase in the size of the kidney. Evidence: TAS. Frequency: Occasional (HP:0040283). (ORPHA:500095)
- Macroglossia (HP:0000158): Increased length and width of the tongue. Evidence: TAS. Frequency: Occasional (HP:0040283). (ORPHA:500095)
- Epicanthus (HP:0000286): A fold of skin starting above the medial aspect of the upper eyelid and arching downward to cover, pass in front of and lateral to the medial canthus. Evidence: TAS. Frequency: Occasional (HP:0040283). (ORPHA:500095)
- Round face (HP:0000311): The facial appearance is more circular than usual as viewed from the front. Evidence: TAS. Frequency: Occasional (HP:0040283). (ORPHA:500095)
- Hypertelorism (HP:0000316): Interpupillary distance more than 2 SD above the mean (alternatively, the appearance of an increased interpupillary distance or widely spaced eyes). Evidence: TAS. Frequency: Occasional (HP:0040283). (ORPHA:500095)
- Macrotia (HP:0000400): Median longitudinal ear length greater than two standard deviations above the mean and median ear width greater than two standard deviations above the mean (objective); or, apparent increase in length and width of the pinna (subjective). Evidence: TAS. Frequency: Occasional (HP:0040283). (ORPHA:500095)
- Protruding ear (HP:0000411): Angle formed by the plane of the ear and the mastoid bone greater than the 97th centile for age (objective); or, outer edge of the helix more than 2 cm from the mastoid at the point of maximum distance (objective). Evidence: TAS. Frequency: Occasional (HP:0040283). (ORPHA:500095)
- Astigmatism (HP:0000483): A type of refraction error associated with abnormal curvatures on the anterior and/or posterior surface of the cornea. Evidence: TAS. Frequency: Occasional (HP:0040283). (ORPHA:500095)
- Strabismus (HP:0000486): A misalignment of the eyes so that the visual axes deviate from bifoveal fixation. The classification of strabismus may be based on a number of features including the relative position of the eyes, whether the deviation is latent or manifest, intermittent or constant, concomitant or otherwise and according to the age of onset and the relevance of any associated refractive error. Evidence: TAS. Frequency: Occasional (HP:0040283). (ORPHA:500095)
- Deeply set eye (HP:0000490): An eye that is more deeply recessed into the plane of the face than is typical. Evidence: TAS. Frequency: Occasional (HP:0040283). (ORPHA:500095)
- Cataract (HP:0000518): A cataract is an opacity or clouding that develops in the crystalline lens of the eye or in its capsule. Evidence: TAS. Frequency: Occasional (HP:0040283). (ORPHA:500095)
- Long palpebral fissure (HP:0000637): Distance between medial and lateral canthi is more than two standard deviations above the mean for age (objective); or, apparently increased length of the palpebral fissures. Evidence: TAS. Frequency: Occasional (HP:0040283). (ORPHA:500095)
- Delayed speech and language development (HP:0000750): A degree of language development that is significantly below the norm for a child of a specified age. Evidence: TAS. Frequency: Occasional (HP:0040283). (ORPHA:500095)
- Abnormal thumb morphology (HP:0001172): An abnormal structure of the first digit of the hand. Evidence: TAS. Frequency: Occasional (HP:0040283). (ORPHA:500095)
- Large hands (HP:0001176). Evidence: TAS. Frequency: Occasional (HP:0040283). (ORPHA:500095)
- Abnormal right ventricle morphology (HP:0001707): An abnormality of the right ventricle of the heart. Evidence: TAS. Frequency: Occasional (HP:0040283). (ORPHA:500095)
- Talipes equinovarus (HP:0001762): Talipes equinovarus (also called clubfoot) typically has four main components: inversion and adduction of the forefoot; inversion of the heel and hindfoot; equinus (limitation of extension) of the ankle and subtalar joint; and internal rotation of the leg. Evidence: TAS. Frequency: Occasional (HP:0040283). (ORPHA:500095)
- Long foot (HP:0001833): Increased back to front length of the foot. Evidence: TAS. Frequency: Occasional (HP:0040283). (ORPHA:500095)
- Metatarsus adductus (HP:0001840): The metatarsals are deviated medially (tibially), that is, the bones in the front half of the foot bend or turn in toward the body. Evidence: TAS. Frequency: Occasional (HP:0040283). (ORPHA:500095)
- Long hallux (HP:0001847): Increased length of the big toe. Evidence: TAS. Frequency: Occasional (HP:0040283). (ORPHA:500095)
- Varicose veins (HP:0002619): Enlarged and tortuous veins. Evidence: TAS. Frequency: Occasional (HP:0040283). (ORPHA:500095)
- Nephroblastoma (HP:0002667): The presence of a nephroblastoma, which is a neoplasm of the kidney that primarily affects children. Evidence: TAS. Frequency: Occasional (HP:0040283). (ORPHA:500095)
- Tibial bowing (HP:0002982): A bending or abnormal curvature of the tibia. Evidence: TAS. Frequency: Occasional (HP:0040283). (ORPHA:500095)
- Spina bifida occulta (HP:0003298): The closed form of spina bifida with incomplete closure of a vertebral body with intact overlying skin. Evidence: TAS. Frequency: Occasional (HP:0040283). (ORPHA:500095)
- Midface retrusion (HP:0011800): Posterior positions and/or vertical shortening of the infraorbital and perialar regions, or increased concavity of the face and/or reduced nasolabial angle. Evidence: TAS. Frequency: Occasional (HP:0040283). (ORPHA:500095)
- Abnormal femoral torsion (HP:0031069): Femoral torsion, also known as femoral rotation or femoral version, refers to the twist between the proximal and distal parts of the femur on the transverse plane. Femoral anteversion averages between 30-40 degrees at birth, and between 8-14 degrees in adults. This term applies if the amount of femoral torsion deviates from this range. Evidence: TAS. Frequency: Occasional (HP:0040283). (ORPHA:500095)
- Tibial torsion (HP:0100694): Twisted position of the tibia (shin bone) associated with pathological rotation of the leg. Evidence: TAS. Frequency: Occasional (HP:0040283). (ORPHA:500095)
These phenotypes are associated with the disease Tall stature-intellectual disability-renal anomalies syndrome (ORPHA:500095).